Phenotypes associated with the disease Generalized eruptive keratoacanthoma (ORPHA:411777):
- Ectropion (HP:0000656): An outward turning (eversion) or rotation of the eyelid margin. Evidence: TAS. Frequency: Frequent (HP:0040282). (ORPHA:411777)
- Pruritus (HP:0000989): Pruritus is an itch or a sensation that makes a person want to scratch. This term refers to an abnormally increased disposition to experience pruritus. Evidence: TAS. Frequency: Frequent (HP:0040282). (ORPHA:411777)
- Papule (HP:0200034): A circumscribed, solid elevation of skin with no visible fluid, varying in size from a pinhead to less than 10mm in diameter at the widest point. Evidence: TAS. Frequency: Frequent (HP:0040282). (ORPHA:411777)
- Abnormal cornea morphology (HP:0000481): Any abnormality of the cornea, which is the transparent tissue at the front of the eye that covers the iris, pupil, and anterior chamber. Evidence: TAS. Frequency: Occasional (HP:0040283). (ORPHA:411777)
- Conjunctivitis (HP:0000509): Inflammation of the conjunctiva. Evidence: TAS. Frequency: Occasional (HP:0040283). (ORPHA:411777)
- Keratoconjunctivitis sicca (HP:0001097): Dryness of the eye related to deficiency of the tear film components (aqueous, mucin, or lipid), lid surface abnormalities, or epithelial abnormalities. Keratoconjunctivitis sicca often results in a scratchy or sandy sensation (foreign body sensation) in the eyes, and may also be associated with itching, inability to produce tears, photosensitivity, redness, pain, and difficulty in moving the eyelids. Evidence: TAS. Frequency: Occasional (HP:0040283). (ORPHA:411777)
- Hoarse voice (HP:0001609): Hoarseness refers to a change in the pitch or quality of the voice, with the voice sounding weak, very breathy, scratchy, or husky. Evidence: TAS. Frequency: Occasional (HP:0040283). (ORPHA:411777)
- Dysphagia (HP:0002015): Difficulty in swallowing. Evidence: TAS. Frequency: Occasional (HP:0040283). (ORPHA:411777)